Phenotypes associated with the disease 3-hydroxyisobutyric aciduria (ORPHA:939):
- Hypogonadotropic hypogonadism (HP:0000044): Hypogonadotropic hypogonadism is characterized by reduced function of the gonads (testes in males or ovaries in females) and results from the absence of the gonadal stimulating pituitary hormones: follicle stimulating hormone (FSH) and luteinizing hormone (LH). Evidence: TAS. Frequency: Very frequent (HP:0040281). (ORPHA:939)
- Lactic acidosis (HP:0003128): An abnormal buildup of lactic acid in the body, leading to acidification of the blood and other bodily fluids. Evidence: TAS. Frequency: Very frequent (HP:0040281). (ORPHA:939)
- Triangular face (HP:0000325): Facial contour, as viewed from the front, triangular in shape, with breadth at the temples and tapering to a narrow chin. Evidence: TAS. Frequency: Frequent (HP:0040282). (ORPHA:939)
- Long philtrum (HP:0000343): Distance between nasal base and midline upper lip vermilion border more than 2 SD above the mean. Alternatively, an apparently increased distance between nasal base and midline upper lip vermilion border. Evidence: TAS. Frequency: Frequent (HP:0040282). (ORPHA:939)
- Microtia (HP:0008551): Underdevelopment of the external ear. Evidence: TAS. Frequency: Frequent (HP:0040282). (ORPHA:939)
- Microcephaly (HP:0000252): Head circumference below 2 standard deviations below the mean for age and gender. Evidence: TAS. Frequency: Occasional (HP:0040283). (ORPHA:939)
- Sloping forehead (HP:0000340): Inclination of the anterior surface of the forehead from the vertical more than two standard deviations above the mean (objective); or apparently excessive posterior sloping of the forehead in a lateral view. Evidence: TAS. Frequency: Occasional (HP:0040283). (ORPHA:939)
- Micrognathia (HP:0000347): Developmental hypoplasia of the mandible. Evidence: TAS. Frequency: Occasional (HP:0040283). (ORPHA:939)
- Seizure (HP:0001250): A seizure is an intermittent abnormality of nervous system physiology characterized by a transient occurrence of signs and/or symptoms due to abnormal excessive or synchronous neuronal activity in the brain. Evidence: TAS. Frequency: Occasional (HP:0040283). (ORPHA:939)
- Intrauterine growth retardation (HP:0001511): An abnormal restriction of fetal growth with fetal weight below the tenth percentile for gestational age. Evidence: TAS. Frequency: Occasional (HP:0040283). (ORPHA:939)
- Ventriculomegaly (HP:0002119): An increase in size of the ventricular system of the brain. Evidence: TAS. Frequency: Occasional (HP:0040283). (ORPHA:939)
- Cerebral cortical atrophy (HP:0002120): Atrophy of the cortex of the cerebrum. Evidence: TAS. Frequency: Occasional (HP:0040283). (ORPHA:939)
- Cerebral calcification (HP:0002514): The presence of calcium deposition within the cerebrum. Evidence: TAS. Frequency: Occasional (HP:0040283). (ORPHA:939)
- Aplasia/Hypoplasia of the cerebellum (HP:0007360). Evidence: TAS. Frequency: Occasional (HP:0040283). (ORPHA:939)
- Aplasia/Hypoplasia of the corpus callosum (HP:0007370): Absence or underdevelopment of the corpus callosum. Evidence: TAS. Frequency: Occasional (HP:0040283). (ORPHA:939)